- Breech presentation (HP:0001623): A position of the fetus at delivery in which the fetus enters the birth canal with the buttocks or feet first. Evidence: TAS. Frequency: Frequent (HP:0040282). (ORPHA:171430)
- Dysphagia (HP:0002015): Difficulty in swallowing. Evidence: TAS. Frequency: Frequent (HP:0040282). (ORPHA:171430)
- Respiratory distress (HP:0002098): Respiratory distress is objectively observable as the physical or emotional consequences from the experience of dyspnea. The physical presentation of respiratory distress is generally referred to as labored breathing, while the sensation of respiratory distress is called shortness of breath or dyspnea. Evidence: TAS. Frequency: Frequent (HP:0040282). (ORPHA:171430)
- Hypokinesia (HP:0002375): Abnormally diminished motor activity. In contrast to paralysis, hypokinesia is not characterized by a lack of motor strength, but rather by a poverty of movement. The typical habitual movements (e.g., folding the arms, crossing the legs) are reduced in frequency. Evidence: TAS. Frequency: Frequent (HP:0040282). (ORPHA:171430)
- Respiratory failure (HP:0002878): A severe form of respiratory insufficiency characterized by inadequate gas exchange such that the levels of oxygen or carbon dioxide cannot be maintained within normal limits. Evidence: TAS. Frequency: Frequent (HP:0040282). (ORPHA:171430)
- Skeletal muscle atrophy (HP:0003202): The presence of skeletal muscular atrophy (which is also known as amyotrophy). Evidence: TAS. Frequency: Frequent (HP:0040282). (ORPHA:171430)
- Axial muscle weakness (HP:0003327): Reduced strength of the axial musculature (i.e., of the muscles of the head and neck, spine, and ribs). Evidence: TAS. Frequency: Frequent (HP:0040282). (ORPHA:171430)
- Nemaline bodies (HP:0003798): Nemaline rods are abnormal bodies that can occur in skeletal muscle fibers. The rods can be observed on histological analysis of muscle biopsy tissue or upon electron microscopy, where they appear either as extensions of sarcomeric Z-lines, in random array without obvious attachment to Z-lines (often in areas devoid of sarcomeres) or in large clusters localized at the sarcolemma or intermyofibrillar spaces. Evidence: TAS. Frequency: Frequent (HP:0040282). (ORPHA:171430)
- Type 1 muscle fiber predominance (HP:0003803): An abnormal predominance of type I muscle fibers (in general, this feature can only be observed on muscle biopsy). Evidence: TAS. Frequency: Frequent (HP:0040282). (ORPHA:171430)
- Multiple prenatal fractures (HP:0005855): The presence of bone fractures in the prenatal period that are diagnosed at birth or before. Evidence: TAS. Frequency: Frequent (HP:0040282). (ORPHA:171430)
- Severe muscular hypotonia (HP:0006829): A severe degree of muscular hypotonia characterized by markedly reduced muscle tone. Evidence: TAS. Frequency: Frequent (HP:0040282). (ORPHA:171430)
- Increased connective tissue (HP:0009025): The presence of an abnormally increased amount of connective tissue. Evidence: TAS. Frequency: Frequent (HP:0040282). (ORPHA:171430)
- Facial palsy (HP:0010628): Facial nerve palsy is a dysfunction of cranial nerve VII (the facial nerve) that results in inability to control facial muscles on the affected side with weakness of the muscles of facial expression and eye closure. This can either be present in unilateral or bilateral form. Evidence: TAS. Frequency: Frequent (HP:0040282). (ORPHA:171430)
- Hypospadias (HP:0000047): Abnormal position of urethral meatus on the ventral penile shaft (underside) characterized by displacement of the urethral meatus from the tip of the glans penis to the ventral surface of the penis, scrotum, or perineum. Evidence: TAS. Frequency: Occasional (HP:0040283). (ORPHA:171430)
- Micropenis (HP:0000054): Abnormally small penis. At birth, the normal penis is about 3 cm (stretched length from pubic tubercle to tip of penis) with micropenis less than 2.0-2.5 cm. Evidence: TAS. Frequency: Occasional (HP:0040283). (ORPHA:171430)
- Large fontanelles (HP:0000239): In newborns, the two frontal bones, two parietal bones, and one occipital bone are joined by fibrous sutures, which form a small posterior fontanelle, and a larger, diamond-shaped anterior fontanelle. These regions allow for the skull to pass the birth canal and for later growth. The fontanelles gradually ossify, whereby the posterior fontanelle usually closes by eight weeks and the anterior fontanelle by the 9th to 16th month of age. Large fontanelles are diagnosed if the fontanelles are larger than age-dependent norms. Evidence: TAS. Frequency: Occasional (HP:0040283). (ORPHA:171430)
- Micrognathia (HP:0000347): Developmental hypoplasia of the mandible. Evidence: TAS. Frequency: Occasional (HP:0040283). (ORPHA:171430)
- Low-set ears (HP:0000369): Upper insertion of the ear to the scalp below an imaginary horizontal line drawn between the inner canthi of the eye and extending posteriorly to the ear. Evidence: TAS. Frequency: Occasional (HP:0040283). (ORPHA:171430)
- Ptosis (HP:0000508): The upper eyelid margin is positioned 3 mm or more lower than usual and covers the superior portion of the iris (objective); or, the upper lid margin obscures at least part of the pupil (subjective). Evidence: TAS. Frequency: Occasional (HP:0040283). (ORPHA:171430)
- Ophthalmoplegia (HP:0000602): Paralysis of one or more extraocular muscles that are responsible for eye movements. Evidence: TAS. Frequency: Occasional (HP:0040283). (ORPHA:171430)
- Abnormality of the diaphragm (HP:0000775): Any abnormality of the diaphragm, the sheet of skeletal muscle that separates the thoracic cavity from the abdominal cavity. Evidence: TAS. Frequency: Occasional (HP:0040283). (ORPHA:171430)
- Thin ribs (HP:0000883): Ribs with a reduced diameter. Evidence: TAS. Frequency: Occasional (HP:0040283). (ORPHA:171430)
- Adducted thumb (HP:0001181): In the resting position, the tip of the thumb is on, or near, the palm, close to the base of the fourth or fifth finger. Evidence: TAS. Frequency: Occasional (HP:0040283). (ORPHA:171430)
- Gait disturbance (HP:0001288): The term gait disturbance can refer to any disruption of the ability to walk. Evidence: TAS. Frequency: Occasional (HP:0040283). (ORPHA:171430)
- Tremor (HP:0001337): An unintentional, oscillating to-and-fro muscle movement about a joint axis. Evidence: TAS. Frequency: Occasional (HP:0040283). (ORPHA:171430)
- Facial diplegia (HP:0001349): Facial diplegia refers to bilateral facial palsy (bilateral facial palsy is much rarer than unilateral facial palsy). Evidence: TAS. Frequency: Occasional (HP:0040283). (ORPHA:171430)
- Premature birth (HP:0001622): The birth of a baby of less than 37 weeks of gestational age. Evidence: TAS. Frequency: Occasional (HP:0040283). (ORPHA:171430)
- Cardiomegaly (HP:0001640): Increased size of the heart, clinically defined as an increased transverse diameter of the cardiac silhouette that is greater than or equal to 50% of the transverse diameter of the chest (increased cardiothoracic ratio) on a posterior-anterior projection of a chest radiograph or a computed tomography. Evidence: TAS. Frequency: Occasional (HP:0040283). (ORPHA:171430)
- Dilated cardiomyopathy (HP:0001644): Dilated cardiomyopathy (DCM) is defined by the presence of left ventricular dilatation and left ventricular systolic dysfunction in the absence of abnormal loading conditions (hypertension, valve disease) or coronary artery disease sufficient to cause global systolic impairment. Right ventricular dilation and dysfunction may be present but are not necessary for the diagnosis. Evidence: TAS. Frequency: Occasional (HP:0040283). (ORPHA:171430)
- Cardiac arrest (HP:0001695): An abrupt loss of heart function. Evidence: TAS. Frequency: Occasional (HP:0040283). (ORPHA:171430)
- Abnormal thorax morphology (HP:0000765): Any abnormality of the thorax (the region of the body formed by the sternum, the thoracic vertebrae and the ribs). Evidence: TAS. Frequency: Frequent (HP:0040282). (ORPHA:171430)
- Motor delay (HP:0001270): A type of Developmental delay characterized by a delay in acquiring motor skills. Evidence: TAS. Frequency: Frequent (HP:0040282). (ORPHA:171430)
- Neonatal hypotonia (HP:0001319): Muscular hypotonia (abnormally low muscle tone) manifesting in the neonatal period. Evidence: TAS. Frequency: Frequent (HP:0040282). (ORPHA:171430)
- Flexion contracture (HP:0001371): A flexion contracture is a bent (flexed) joint that cannot be straightened actively or passively. It is thus a chronic loss of joint motion due to structural changes in muscle, tendons, ligaments, or skin that prevents normal movement of joints. Evidence: TAS. Frequency: Frequent (HP:0040282). (ORPHA:171430)
- Decreased fetal movement (HP:0001558): An abnormal reduction in quantity or strength of fetal movements. Evidence: TAS. Frequency: Frequent (HP:0040282). (ORPHA:171430)
- Polyhydramnios (HP:0001561): The presence of excess amniotic fluid in the uterus during pregnancy. Evidence: TAS. Frequency: Frequent (HP:0040282). (ORPHA:171430)
- Talipes equinovarus (HP:0001762): Talipes equinovarus (also called clubfoot) typically has four main components: inversion and adduction of the forefoot; inversion of the heel and hindfoot; equinus (limitation of extension) of the ankle and subtalar joint; and internal rotation of the leg. Evidence: TAS. Frequency: Occasional (HP:0040283). (ORPHA:171430)
- Pulmonary hypoplasia (HP:0002089). Evidence: TAS. Frequency: Occasional (HP:0040283). (ORPHA:171430)
- Falls (HP:0002527). Evidence: TAS. Frequency: Occasional (HP:0040283). (ORPHA:171430)
- Scoliosis (HP:0002650): The presence of an abnormal lateral curvature of the spine. Evidence: TAS. Frequency: Occasional (HP:0040283). (ORPHA:171430)
- Arthrogryposis multiplex congenita (HP:0002804): Multiple congenital contractures in different body areas. Evidence: TAS. Frequency: Occasional (HP:0040283). (ORPHA:171430)
- Edema of the dorsum of hands (HP:0007514): An abnormal accumulation of fluid beneath the skin on the back of the hands. Evidence: TAS. Frequency: Occasional (HP:0040283). (ORPHA:171430)
- Feeding difficulties in infancy (HP:0008872): Impaired feeding performance of an infant as manifested by difficulties such as weak and ineffective sucking, brief bursts of sucking, and falling asleep during sucking. There may be difficulties with chewing or maintaining attention. Evidence: TAS. Frequency: Occasional (HP:0040283). (ORPHA:171430)
These phenotypes are associated with the disease Severe congenital nemaline myopathy (ORPHA:171430).